Phenotypes associated with the disease gastric cancer (OMIM:613659):
- Typified by somatic mosaicism (HP:0001442): Description of conditions in which affected individuals typically display somatic mosaicism, i.e., genetically distinct populations of somatic cells in a given organism caused by DNA mutations, epigenetic alterations of DNA, chromosomal abnormalities or the spontaneous reversion of inherited mutations. In many conditions typified by somatic mosaicism, constitutive mutation is lethal and cases are exclusively or predominantly mosaic. Evidence: TAS. (OMIM:613659)
- Increased level of L-fucose in urine (HP:0410067): An increase in the level of L-fucose in the urine. Evidence: PCS. (PMID:2311216)
- Stomach cancer (HP:0012126): A cancer arising in any part of the stomach. Evidence: TAS. (OMIM:613659)